- Congenital onset (HP:0003577): A phenotypic abnormality that is present at birth. Evidence: PCS. Frequency: 8/8. (PMID:17211611)
- Abnormal vestibular function (HP:0001751): An abnormality of the functioning of the vestibular apparatus. Evidence: PCS. Frequency: 0/4. (PMID:17211611)
- Abnormal fundus morphology (HP:0001098): Any structural abnormality of the fundus of the eye. Evidence: PCS. Frequency: 0/4. (PMID:18953341)
- Autosomal recessive inheritance (HP:0000007): A mode of inheritance that is observed for traits related to a gene encoded on one of the autosomes (i.e., the human chromosomes 1-22) in which a trait manifests in individuals with two pathogenic alleles, either homozygotes (two copies of the same mutant allele) or compound heterozygotes (whereby each copy of a gene has a distinct mutant allele). Evidence: PCS. (PMID:18794526)
- Congenital sensorineural hearing impairment (HP:0008527): A type of hearing impairment caused by an abnormal functionality of the cochlear nerve with congenital onset. Evidence: PCS. Onset: Congenital onset (HP:0003577). (PMID:18794526)
These phenotypes are associated with the disease autosomal recessive nonsyndromic hearing loss 63 (OMIM:611451).